- Agenesis of mandibular premolar (HP:0011053): Agenesis of mandibular premolar. Evidence: PCS. Frequency: 2/9. (PMID:38791218)
- Agenesis of maxillary premolar (HP:0011052): Agenesis of maxillary premolar. Evidence: PCS. Frequency: 2/9. (PMID:38791218)
- Agenesis of second permanent molar (HP:0011057): Agenesis of either mandibular second permanent molar or maxillary second permanent molar. Evidence: PCS. Frequency: 2/9. (PMID:38791218)
- Agenesis of first permanent molar tooth (HP:0011056): Agenesis of either maxillary first permanent molar or mandibular first permanent molar or both. Evidence: PCS. Frequency: 1/9. (PMID:38791218)
- Torus palatinus (HP:0100789): A bony protrusion present on the midline of the hard palate. Evidence: PCS. Frequency: 2/9. (PMID:38791218)
- Microdontia (HP:0000691): Decreased size of the teeth, which can be defined as a mesiodistal tooth diameter (width) more than 2 SD below mean. Alternatively, an apparently decreased maximum width of tooth. Evidence: PCS. Frequency: 1/9. (PMID:38791218)
- Radiculomegaly (HP:0033189): Tooth root length more than 2 SD above mean, or subjectively apparently increased tooth root length. Evidence: PCS. Frequency: 2/9. (PMID:38791218)
- Hypoplasia of the dental root (HP:0040221). Evidence: PCS. Frequency: 2/9. (PMID:38791218)
- Taurodontia (HP:0000679): Increased volume of dental pulp of permanent molar characterized by a crown body-root ratio equal or larger than 1:1 or an elongated pulp chambers and apical displacement of the bifurcation or trifurcation of the roots. Evidence: PCS. Frequency: 8/9. (PMID:38791218)
- Supernumerary tooth (HP:0011069): The presence of one or more teeth additional to the normal number. Evidence: PCS. Frequency: 1/9. (PMID:38791218)
- Short dental root (HP:0006336): Tooth root length more than 2 SD below mean, or subjectively apparently decreased tooth root length. Evidence: PCS. Frequency: 2/9. (PMID:38791218)
- Autosomal dominant inheritance (HP:0000006): A mode of inheritance that is observed for traits related to a gene encoded on one of the autosomes (i.e., the human chromosomes 1-22) in which a trait manifests in heterozygotes. In the context of medical genetics, an autosomal dominant disorder is caused when a single copy of the mutant allele is present. Males and females are affected equally, and can both transmit the disorder with a risk of 50% for each child of inheriting the mutant allele. Evidence: PCS. (PMID:38791218)
These phenotypes are associated with the disease dental radicular dysplasia (OMIM:621434).